- Autosomal recessive inheritance (HP:0000007): A mode of inheritance that is observed for traits related to a gene encoded on one of the autosomes (i.e., the human chromosomes 1-22) in which a trait manifests in individuals with two pathogenic alleles, either homozygotes (two copies of the same mutant allele) or compound heterozygotes (whereby each copy of a gene has a distinct mutant allele). Evidence: TAS. (OMIM:611095)
- Motor delay (HP:0001270): A type of Developmental delay characterized by a delay in acquiring motor skills. Evidence: TAS. (OMIM:611095)
- Growth delay (HP:0001510): A deficiency or slowing down of growth pre- and postnatally. Evidence: TAS. (OMIM:611095)
- Spasticity (HP:0001257): A motor disorder characterized by a velocity-dependent increase in tonic stretch reflexes with increased muscle tone, exaggerated (hyperexcitable) tendon reflexes. Evidence: IEA. (OMIM:611095)
- Intellectual disability (HP:0001249): The term intellectual disability or intellectual developmental disorder is used to describe significantly sub-average intellectual and adaptive functioning based on clinical assessment and as measured by individually administered, appropriately normed, standardized and validated tests of intellectual functioning and adaptive behavior, with onset during the developmental period from infancy through adolescence. Evidence: TAS. (OMIM:611095)
- Severe intellectual disability (HP:0010864): Severe intellectual disability (ID) is defined as a type of ID characterized by severely sub-average adaptive functioning and intellectual functioning, with an intelligence quotient (IQ) the range of 20-34. Evidence: TAS. (OMIM:611095)
These phenotypes are associated with the disease intellectual disability, autosomal recessive 9 (OMIM:611095).